Phenotypes associated with the disease Discoid lupus erythematosus (ORPHA:90281):
- Hypopigmentation of the skin (HP:0001010): A reduction of skin color related to a decrease in melanin production and deposition. Evidence: TAS. Frequency: Frequent (HP:0040282). (ORPHA:90281)
- Atrophic scars (HP:0001075): Scars that form a depression compared to the level of the surrounding skin because of damage to the collagen, fat or other tissues below the skin. Evidence: TAS. Frequency: Frequent (HP:0040282). (ORPHA:90281)
- Scarring alopecia of scalp (HP:0004552). Evidence: TAS. Frequency: Frequent (HP:0040282). (ORPHA:90281)
- Follicular hyperkeratosis (HP:0007502): A skin condition characterized by excessive development of keratin in hair follicles, resulting in rough, cone-shaped, elevated papules resulting from closure of hair follicles with a white plug of sebum. Evidence: TAS. Frequency: Frequent (HP:0040282). (ORPHA:90281)
- Erythematous plaque (HP:0025474): A plaque (a solid, raised, plateau-like (flat-topped) lesion greater than 1 cm in diameter) with a red or reddish color often associated with inflammation or irritation. Evidence: TAS. Frequency: Frequent (HP:0040282). (ORPHA:90281)
- Erythematous papule (HP:0030350): A circumscribed, solid elevation of skin with no visible fluid that is reddish (erythematous) in color. Evidence: TAS. Frequency: Frequent (HP:0040282). (ORPHA:90281)
- Telangiectasia of the skin (HP:0100585): Presence of small, permanently dilated blood vessels near the surface of the skin, visible as small focal red lesions. Evidence: TAS. Frequency: Frequent (HP:0040282). (ORPHA:90281)
- Positive lupus band test (HP:4000107): Deposits of immunoglobulins and complement components along the dermoepidermal junction. Evidence: TAS. Frequency: Frequent (HP:0040282). (ORPHA:90281)
- Arthralgia (HP:0002829): Joint pain. Evidence: TAS. Frequency: Occasional (HP:0040283). (ORPHA:90281)
- Squamous cell carcinoma of the skin (HP:0006739): Squamous cell carcinoma of the skin is a malignant tumor of squamous epithelium. Evidence: TAS. Frequency: Very rare (HP:0040284). (ORPHA:90281)